Phenotypes associated with the disease Gelatinous drop-like corneal dystrophy (ORPHA:98957):
- Photophobia (HP:0000613): Excessive sensitivity to light with the sensation of discomfort or pain in the eyes due to exposure to bright light. Evidence: TAS. Frequency: Very frequent (HP:0040281). (ORPHA:98957)
- Blurred vision (HP:0000622): Lack of sharpness of vision resulting in the inability to see fine detail. Evidence: TAS. Frequency: Very frequent (HP:0040281). (ORPHA:98957)
- Blepharospasm (HP:0000643): A focal dystonia that affects the muscles of the eyelids and brow, associated with involuntary recurrent spasm of both eyelids. Evidence: TAS. Frequency: Frequent (HP:0040282). (ORPHA:98957)
- Reduced visual acuity (HP:0007663). Evidence: TAS. Frequency: Frequent (HP:0040282). (ORPHA:98957)
- Subepithelial corneal opacities (HP:0008039). Evidence: TAS. Frequency: Frequent (HP:0040282). (ORPHA:98957)
- Epiphora (HP:0009926): Abnormally increased lacrimation, that is, excessive tearing (watering eye). Evidence: TAS. Frequency: Frequent (HP:0040282). (ORPHA:98957)
- Conjunctival amyloidosis (HP:0010637): A form of amyloidosis that affects the conjunctiva. Evidence: TAS. Frequency: Frequent (HP:0040282). (ORPHA:98957)
- Corneal neovascularization (HP:0011496): Ingrowth of new blood vessels into the cornea. Evidence: TAS. Frequency: Frequent (HP:0040282). (ORPHA:98957)
- Corneal foreign body sensation (HP:0034804): A perception that an object is in contact with the eye. Evidence: TAS. Frequency: Frequent (HP:0040282). (ORPHA:98957)
- Ocular pain (HP:0200026): An unpleasant sensation characterized by physical discomfort (such as pricking, throbbing, or aching) localized to the eye. Evidence: TAS. Frequency: Frequent (HP:0040282). (ORPHA:98957)
- Central opacification of the cornea (HP:0011493): Reduced transparency of the central portion of the corneal stroma. Evidence: TAS. Frequency: Occasional (HP:0040283). (ORPHA:98957)